- Narrow mouth (HP:0000160): Distance between the commissures of the mouth more than 2 SD below the mean. Alternatively, an apparently decreased width of the oral aperture (subjective). Evidence: TAS. Frequency: Very frequent (HP:0040281). (ORPHA:2588)
- Thin vermilion border (HP:0000233): Height of the vermilion of the medial part of the lip more than 2 SD below the mean, or apparently reduced height of the vermilion of the lip in the frontal view. The vermilion is the red part of the lips (and confusingly, the vermilion itself is also often referred to as being equivalent the lips). Evidence: TAS. Frequency: Very frequent (HP:0040281). (ORPHA:2588)
- Mandibular prognathia (HP:0000303): Abnormal prominence of the chin related to increased length of the mandible. Evidence: TAS. Frequency: Very frequent (HP:0040281). (ORPHA:2588)
- Hypoplasia of the maxilla (HP:0000327): Abnormally small dimension of the Maxilla. Usually creating a malocclusion or malalignment between the upper and lower teeth or resulting in a deficient amount of projection of the base of the nose and lower midface region. Evidence: TAS. Frequency: Very frequent (HP:0040281). (ORPHA:2588)
- Hearing impairment (HP:0000365): A decreased magnitude of the sensory perception of sound. Evidence: TAS. Frequency: Very frequent (HP:0040281). (ORPHA:2588)
- Abnormal rib morphology (HP:0000772): An anomaly of the rib. Evidence: TAS. Frequency: Very frequent (HP:0040281). (ORPHA:2588)
- Platyspondyly (HP:0000926): A flattened vertebral body shape with reduced distance between the vertebral endplates. Evidence: TAS. Frequency: Very frequent (HP:0040281). (ORPHA:2588)
- Brachydactyly (HP:0001156): Digits that appear disproportionately short compared to the hand/foot. The word brachydactyly is used here to describe a series distinct patterns of shortened digits (brachydactyly types A-E). This is the sense used here. Evidence: TAS. Frequency: Very frequent (HP:0040281). (ORPHA:2588)
- Intellectual disability (HP:0001249): The term intellectual disability or intellectual developmental disorder is used to describe significantly sub-average intellectual and adaptive functioning based on clinical assessment and as measured by individually administered, appropriately normed, standardized and validated tests of intellectual functioning and adaptive behavior, with onset during the developmental period from infancy through adolescence. Evidence: TAS. Frequency: Very frequent (HP:0040281). (ORPHA:2588)
- Global developmental delay (HP:0001263): A delay in the achievement of motor or mental milestones in the domains of development of a child, including motor skills, speech and language, cognitive skills, and social and emotional skills. This term should only be used to describe children younger than five years of age. Evidence: TAS. Frequency: Very frequent (HP:0040281). (ORPHA:2588)
- Specific learning disability (HP:0001328): Impairment of certain skills such as reading or writing, coordination, self-control, or attention that interfere with the ability to learn. The impairment is not related to a global deficiency of intelligence. Evidence: TAS. Frequency: Very frequent (HP:0040281). (ORPHA:2588)
- Joint stiffness (HP:0001387): Joint stiffness is a perceived sensation of tightness in a joint or joints when attempting to move them after a period of inactivity. Joint stiffness typically subsides over time. Evidence: TAS. Frequency: Very frequent (HP:0040281). (ORPHA:2588)
- Intrauterine growth retardation (HP:0001511): An abnormal restriction of fetal growth with fetal weight below the tenth percentile for gestational age. Evidence: TAS. Frequency: Very frequent (HP:0040281). (ORPHA:2588)
- Abnormal pubic bone morphology (HP:0003172): An anomaly of the the pubic bone, i.e., of the ventral and anterior of the three principal components (pubis, ilium, ischium) of the hip bone. Evidence: TAS. Frequency: Very frequent (HP:0040281). (ORPHA:2588)
- Severe short stature (HP:0003510): A severe degree of short stature, more than -4 SD from the mean corrected for age and sex. Evidence: TAS. Frequency: Very frequent (HP:0040281). (ORPHA:2588)
- Skeletal muscle hypertrophy (HP:0003712): Abnormal increase in muscle size and mass not due to training. Evidence: TAS. Frequency: Very frequent (HP:0040281). (ORPHA:2588)
- Short palm (HP:0004279): Short palm. Evidence: TAS. Frequency: Very frequent (HP:0040281). (ORPHA:2588)
- Craniofacial hyperostosis (HP:0004493): Excessive growth of the craniofacial bones. Evidence: TAS. Frequency: Very frequent (HP:0040281). (ORPHA:2588)
- Large iliac wing (HP:0008818): Increased size of the ilium ala. Evidence: TAS. Frequency: Very frequent (HP:0040281). (ORPHA:2588)
- Midface retrusion (HP:0011800): Posterior positions and/or vertical shortening of the infraorbital and perialar regions, or increased concavity of the face and/or reduced nasolabial angle. Evidence: TAS. Frequency: Very frequent (HP:0040281). (ORPHA:2588)
- Cryptorchidism (HP:0000028): Testis in inguinal canal. That is, absence of one or both testes from the scrotum owing to failure of the testis or testes to descend through the inguinal canal to the scrotum. Evidence: TAS. Frequency: Frequent (HP:0040282). (ORPHA:2588)
- Abnormal lip morphology (HP:0000159): An abnormality of the lip. Evidence: TAS. Frequency: Frequent (HP:0040282). (ORPHA:2588)
- Ptosis (HP:0000508): The upper eyelid margin is positioned 3 mm or more lower than usual and covers the superior portion of the iris (objective); or, the upper lid margin obscures at least part of the pupil (subjective). Evidence: TAS. Frequency: Frequent (HP:0040282). (ORPHA:2588)
- Blepharophimosis (HP:0000581): A fixed reduction in the vertical distance between the upper and lower eyelids with short palpebral fissures. Evidence: TAS. Frequency: Frequent (HP:0040282). (ORPHA:2588)
- Hypertension (HP:0000822): The presence of chronic increased pressure in the systemic arterial system. Evidence: TAS. Frequency: Frequent (HP:0040282). (ORPHA:2588)
- Abnormal metaphysis morphology (HP:0000944): An abnormality of one or more metaphysis, i.e., of the somewhat wider portion of a long bone that is adjacent to the epiphyseal growth plate and grows during childhood. Evidence: TAS. Frequency: Frequent (HP:0040282). (ORPHA:2588)
- Thickened skin (HP:0001072): Laminar thickening of skin. Evidence: TAS. Frequency: Frequent (HP:0040282). (ORPHA:2588)
- Abnormal cardiac septum morphology (HP:0001671): An anomaly of the intra-atrial or intraventricular septum. Evidence: TAS. Frequency: Frequent (HP:0040282). (ORPHA:2588)
- EMG abnormality (HP:0003457): Abnormal results of investigations using electromyography (EMG). Evidence: TAS. Frequency: Frequent (HP:0040282). (ORPHA:2588)
- Abnormal epiphysis morphology (HP:0005930): An anomaly of epiphysis, which is the expanded articular end of a long bone that developes from a secondary ossification center, and which during the period of growth is either entirely cartilaginous or is separated from the shaft by a cartilaginous disk. Evidence: TAS. Frequency: Frequent (HP:0040282). (ORPHA:2588)
- High hypermetropia (HP:0008499): A severe form of hypermetropia with over +5.00 diopters. Evidence: TAS. Frequency: Frequent (HP:0040282). (ORPHA:2588)
- Short palpebral fissure (HP:0012745): Distance between the medial and lateral canthi is more than 2 SD below the mean for age (objective); or, apparently reduced length of the palpebral fissures. Evidence: TAS. Frequency: Frequent (HP:0040282). (ORPHA:2588)
- Inguinal hernia (HP:0000023): Protrusion of the contents of the abdominal cavity through the inguinal canal. Evidence: TAS. Frequency: Occasional (HP:0040283). (ORPHA:2588)
- Abnormal penis morphology (HP:0000036): Abnormality of the male external sex organ. Evidence: TAS. Frequency: Occasional (HP:0040283). (ORPHA:2588)
- Epispadias (HP:0000039): Epispadias is a urogenital malformation characterized by the failure of the urethral tube to tubularize on the dorsal aspect. Unlike in hypospadias, where the meatus is on the ventral aspect, children with epispadias have a wide-open urethral plate on the dorsum. It is commonly seen as a component in the spectrum of bladder exstrophy-epispadias-complex. Isolated epispadias constitutes less than 10 percent of the total cases of epispadias. Evidence: TAS. Frequency: Occasional (HP:0040283). (ORPHA:2588)
- Hypospadias (HP:0000047): Abnormal position of urethral meatus on the ventral penile shaft (underside) characterized by displacement of the urethral meatus from the tip of the glans penis to the ventral surface of the penis, scrotum, or perineum. Evidence: TAS. Frequency: Occasional (HP:0040283). (ORPHA:2588)
- Hypogonadism (HP:0000135): A decreased functionality of the gonad. Evidence: TAS. Frequency: Occasional (HP:0040283). (ORPHA:2588)
- Cleft palate (HP:0000175): Cleft palate is a developmental defect of the palate resulting from a failure of fusion of the palatine processes and manifesting as a separation of the roof of the mouth (soft and hard palate). Evidence: TAS. Frequency: Occasional (HP:0040283). (ORPHA:2588)
- Submucous cleft hard palate (HP:0000176): Hard-palate submucous clefts are characterized by bony defects in the midline of the bony palate that are covered by the mucous membrane of the roof of the mouth. It may be possible to detect a submucous cleft hard palate upon palpation as a notch in the bony palate. Evidence: TAS. Frequency: Occasional (HP:0040283). (ORPHA:2588)
- Bifid uvula (HP:0000193): Uvula separated into two parts most easily seen at the tip. Evidence: TAS. Frequency: Occasional (HP:0040283). (ORPHA:2588)
- Cataract (HP:0000518): A cataract is an opacity or clouding that develops in the crystalline lens of the eye or in its capsule. Evidence: TAS. Frequency: Occasional (HP:0040283). (ORPHA:2588)
- Atypical behavior (HP:0000708): Atypical behavior is an abnormality in a person's actions that can be controlled or modulated by the will of the individual. While abnormal behaviors can be difficult to control, they are distinct from other abnormal actions that cannot be affected by the individual's will. Evidence: TAS. Frequency: Occasional (HP:0040283). (ORPHA:2588)
- Precocious puberty (HP:0000826): The onset of secondary sexual characteristics before a normal age. Although it is difficult to define normal age ranges because of the marked variation with which puberty begins in normal children, precocious puberty can be defined as the onset of puberty before the age of 8 years in girls or 9 years in boys. Evidence: TAS. Frequency: Occasional (HP:0040283). (ORPHA:2588)
- External genital hypoplasia (HP:0003241): Underdevelopment of part or all of the external reproductive organs. Evidence: TAS. Frequency: Occasional (HP:0040283). (ORPHA:2588)
- Gingival cleft (HP:0030690): A fissure in the gingiva (gums), i.e., the mucosal tissue that lies over the mandible and maxilla. Evidence: TAS. Frequency: Occasional (HP:0040283). (ORPHA:2588)
- Unilateral cleft lip (HP:0100333): A non-midline cleft of the upper lip on one side only. Evidence: TAS. Frequency: Occasional (HP:0040283). (ORPHA:2588)
- Femoral hernia (HP:0100541): A hernia which occurs just below the inguinal ligament, where abdominal contents pass through a naturally occurring weakness called the femoral canal. Evidence: TAS. Frequency: Occasional (HP:0040283). (ORPHA:2588)
These phenotypes are associated with the disease Myhre syndrome (ORPHA:2588).